- Severe short stature (HP:0003510): A severe degree of short stature, more than -4 SD from the mean corrected for age and sex. Evidence: IEA. (OMIM:127100)
- Abnormality of the face (HP:0000271): An abnormality of the face. Evidence: IEA. (OMIM:127100)
- Small for gestational age (HP:0001518): Smaller than normal size according to sex and gestational age related norms, defined as a weight below the 10th percentile for the gestational age. Evidence: IEA. (OMIM:127100)
- Autosomal recessive inheritance (HP:0000007): A mode of inheritance that is observed for traits related to a gene encoded on one of the autosomes (i.e., the human chromosomes 1-22) in which a trait manifests in individuals with two pathogenic alleles, either homozygotes (two copies of the same mutant allele) or compound heterozygotes (whereby each copy of a gene has a distinct mutant allele). Evidence: IEA. (OMIM:127100)
- Autosomal dominant inheritance (HP:0000006): A mode of inheritance that is observed for traits related to a gene encoded on one of the autosomes (i.e., the human chromosomes 1-22) in which a trait manifests in heterozygotes. In the context of medical genetics, an autosomal dominant disorder is caused when a single copy of the mutant allele is present. Males and females are affected equally, and can both transmit the disorder with a risk of 50% for each child of inheriting the mutant allele. Evidence: IEA. (OMIM:127100)
These phenotypes are associated with the disease dwarfism, Levi type (OMIM:127100).